Phenotypes associated with the disease retinitis pigmentosa 62 (OMIM:614181):
- Spicular pigmentation of the retina (HP:0007737): Pigment migration into the retina in a bone-spicule configuration (resembling the nucleated cells within the lacuna of bone). Evidence: PCS. Frequency: 3/4. (PMID:21835304)
- Nyctalopia (HP:0000662): Inability to see well at night or in poor light. Evidence: PCS. Frequency: 7/8. (PMID:21835304)
- Middle age onset (HP:0003596): A type of adult onset with onset of symptoms at the age of 40 to 60 years. Evidence: PCS. Frequency: 2/8. (PMID:21835304)
- Visual field defect (HP:0001123). Evidence: PCS. Frequency: 7/7. (PMID:21835304)
- Young adult onset (HP:0011462): Onset of disease at the age of between 16 and 40 years. Evidence: PCS. Frequency: 6/8. (PMID:21835304)
- Autosomal recessive inheritance (HP:0000007): A mode of inheritance that is observed for traits related to a gene encoded on one of the autosomes (i.e., the human chromosomes 1-22) in which a trait manifests in individuals with two pathogenic alleles, either homozygotes (two copies of the same mutant allele) or compound heterozygotes (whereby each copy of a gene has a distinct mutant allele). Evidence: PCS. (PMID:21835304)
- Reduced visual acuity (HP:0007663). Evidence: PCS. Frequency: 8/8. (PMID:21835304)
- Optic disc pallor (HP:0000543): A pale yellow discoloration of the optic disc (the area of the optic nerve head in the retina). The optic disc normally has a pinkish hue with a central yellowish depression. Evidence: PCS. Frequency: 2/8. (PMID:21835304)
- Rod-cone dystrophy (HP:0000510): An inherited retinal disease subtype in which the rod photoreceptors appear to be more severely affected than the cone photoreceptors. Typical presentation is with nyctalopia (due to rod dysfunction) followed by loss of mid-peripheral field of vision, which gradually extends and leaves many patients with a small central island of vision due to the preservation of macular cones. Evidence: PCS. (PMID:21835304)
- Attenuation of retinal blood vessels (HP:0007843): Narrowing of the retinal blood vessels, both arterioles and venules. Evidence: PCS. Frequency: 4/8. (PMID:21835304)
- Bull's eye maculopathy (HP:0011504): Progressive maculopathy characterized by concentric regions of hyper- and hypopigmentation, with an initial foveal sparing and whose appearance is said to resemble the central target of a dart board. Evidence: PCS. Frequency: 1/8. (PMID:21835304)